- Foot dorsiflexor weakness (HP:0009027): Weakness of the muscles responsible for dorsiflexion of the foot, that is, of the movement of the toes towards the shin. The foot dorsiflexors include the tibialis anterior, the extensor hallucis longus, the extensor digitorum longus, and the peroneus tertius muscles. Evidence: TAS. Frequency: Frequent (HP:0040282). (ORPHA:477817)
- Abnormal renal morphology (HP:0012210): Any structural anomaly of the kidney. Evidence: TAS. Frequency: Frequent (HP:0040282). (ORPHA:477817)
- Chronic constipation (HP:0012450): Constipation for longer than three months with fewer than 3 bowel movements per week, straining, lumpy or hard stools, and a sensation of anorectal obstruction or incomplete defecation. Evidence: TAS. Frequency: Frequent (HP:0040282). (ORPHA:477817)
- Decreased/absent ankle reflexes (HP:0200101). Evidence: TAS. Frequency: Frequent (HP:0040282). (ORPHA:477817)
- Brain imaging abnormality (HP:0410263): An anomaly of metabolism or structure of the brain identified by imaging. Evidence: TAS. Frequency: Frequent (HP:0040282). (ORPHA:477817)
- Thin upper lip vermilion (HP:0000219): Height of the vermilion of the upper lip in the midline more than 2 SD below the mean. Alternatively, an apparently reduced height of the vermilion of the upper lip in the frontal view (subjective). Evidence: TAS. Frequency: Occasional (HP:0040283). (ORPHA:477817)
- Smooth philtrum (HP:0000319): Flat skin surface, with no ridge formation in the central region of the upper lip between the nasal base and upper vermilion border. Evidence: TAS. Frequency: Occasional (HP:0040283). (ORPHA:477817)
- Triangular face (HP:0000325): Facial contour, as viewed from the front, triangular in shape, with breadth at the temples and tapering to a narrow chin. Evidence: TAS. Frequency: Occasional (HP:0040283). (ORPHA:477817)
- Long philtrum (HP:0000343): Distance between nasal base and midline upper lip vermilion border more than 2 SD above the mean. Alternatively, an apparently increased distance between nasal base and midline upper lip vermilion border. Evidence: TAS. Frequency: Occasional (HP:0040283). (ORPHA:477817)
- Abnormal pinna morphology (HP:0000377): An abnormality of the pinna, which is also referred to as the auricle or external ear. Evidence: TAS. Frequency: Occasional (HP:0040283). (ORPHA:477817)
- Wide nose (HP:0000445): Interalar distance more than two standard deviations above the mean for age, i.e., an apparently increased width of the nasal base and alae. Evidence: TAS. Frequency: Occasional (HP:0040283). (ORPHA:477817)
- Strabismus (HP:0000486): A misalignment of the eyes so that the visual axes deviate from bifoveal fixation. The classification of strabismus may be based on a number of features including the relative position of the eyes, whether the deviation is latent or manifest, intermittent or constant, concomitant or otherwise and according to the age of onset and the relevance of any associated refractive error. Evidence: TAS. Frequency: Occasional (HP:0040283). (ORPHA:477817)
- Downslanted palpebral fissures (HP:0000494): The palpebral fissure inclination is more than two standard deviations below the mean. Evidence: TAS. Frequency: Occasional (HP:0040283). (ORPHA:477817)
- Decreased nerve conduction velocity (HP:0000762): A reduction in the speed at which electrical signals propagate along the axon of a neuron. Evidence: TAS. Frequency: Occasional (HP:0040283). (ORPHA:477817)
- Sensory neuropathy (HP:0000763): Peripheral neuropathy affecting the sensory nerves. Evidence: TAS. Frequency: Occasional (HP:0040283). (ORPHA:477817)
- Ventricular septal defect (HP:0001629): A hole between the two bottom chambers (ventricles) of the heart. The defect is centered around the most superior aspect of the ventricular septum. Evidence: TAS. Frequency: Occasional (HP:0040283). (ORPHA:477817)
- Atrial septal defect (HP:0001631): Atrial septal defect (ASD) is a congenital abnormality of the interatrial septum that enables blood flow between the left and right atria via the interatrial septum. Evidence: TAS. Frequency: Occasional (HP:0040283). (ORPHA:477817)
- Bicuspid aortic valve (HP:0001647): The presence of an aortic valve with two instead of the normal three cusps (flaps). Bicuspid aortic valvue is a malformation of a commissure (small space between the attachment of each cusp to the aortic wall) and the adjacent parts of the two corresponding cusps forming a raphe (the fused area of the two underdeveloped cusps turning into a malformed commissure between both cusps; the raphe is a fibrous ridge that extends from the commissure to the free edge of the two underdeveloped, conjoint cusps). Evidence: TAS. Frequency: Occasional (HP:0040283). (ORPHA:477817)
- Patent foramen ovale (HP:0001655): Failure of the foramen ovale to seal postnatally, leaving a potential conduit between the left and right cardiac atria. Evidence: TAS. Frequency: Occasional (HP:0040283). (ORPHA:477817)
- Double outlet right ventricle (HP:0001719): Double outlet right ventricle (DORV) is a type of ventriculoarterial connection in which both great vessels arise entirely or predominantly from the right ventricle. Evidence: TAS. Frequency: Occasional (HP:0040283). (ORPHA:477817)
- Talipes equinovarus (HP:0001762): Talipes equinovarus (also called clubfoot) typically has four main components: inversion and adduction of the forefoot; inversion of the heel and hindfoot; equinus (limitation of extension) of the ankle and subtalar joint; and internal rotation of the leg. Evidence: TAS. Frequency: Occasional (HP:0040283). (ORPHA:477817)
- Pes planus (HP:0001763): A foot where the longitudinal arch of the foot is in contact with the ground or floor when the individual is standing; or, in a patient lying supine, a foot where the arch is in contact with the surface of a flat board pressed against the sole of the foot by the examiner with a pressure similar to that expected from weight bearing; or, the height of the arch is reduced. Evidence: TAS. Frequency: Occasional (HP:0040283). (ORPHA:477817)
- Sandal gap (HP:0001852): A widely spaced gap between the first toe (the great toe) and the second toe. Evidence: TAS. Frequency: Occasional (HP:0040283). (ORPHA:477817)
- Broad-based gait (HP:0002136): An abnormal gait pattern in which persons stand and walk with their feet spaced widely apart. This is often a component of cerebellar ataxia. Evidence: TAS. Frequency: Occasional (HP:0040283). (ORPHA:477817)
- Overriding aorta (HP:0002623): An overriding aorta is a congenital heart defect where the aorta is positioned directly over a ventricular septal defect, instead of over the left ventricle. The result is that the aorta receives some blood from the right ventricle, which reduces the amount of oxygen in the blood. It is one of the four conditions of the Tetralogy of Fallot. The aortic root can be displaced toward the front (anteriorly) or directly above the septal defect, but it is always abnormally located to the right of the root of the pulmonary artery. The degree of override is quite variable, with 5-95% of the valve being connected to the right ventricle. Evidence: TAS. Frequency: Occasional (HP:0040283). (ORPHA:477817)
- Decreased number of peripheral myelinated nerve fibers (HP:0003380): A loss of myelinated nerve fibers in the peripheral nervous system (in general, this finding can be observed on nerve biopsy). Evidence: TAS. Frequency: Occasional (HP:0040283). (ORPHA:477817)
- Syringomyelia (HP:0003396): Dilated, glial-lined cavity in spinal cord. This cavity does not communicate with the central canal, and usually is between the dorsal columns unilaterally or bilaterally along the side of the cord. Evidence: TAS. Frequency: Occasional (HP:0040283). (ORPHA:477817)
- 2-3 toe syndactyly (HP:0004691): Syndactyly with fusion of toes two and three. Evidence: TAS. Frequency: Occasional (HP:0040283). (ORPHA:477817)
- Aortic aneurysm (HP:0004942): Aortic dilatation refers to a dimension that is greater than the 95th percentile for the normal person age, sex and body size. In contrast, an aneurysm is defined as a localized dilation of the aorta that is more than 150 percent of predicted (ratio of observed to expected diameter 1.5 or more). Aneurysm should be distinguished from ectasia, which represents a diffuse dilation of the aorta less than 50 percent of normal aorta diameter. Evidence: TAS. Frequency: Occasional (HP:0040283). (ORPHA:477817)
- Persistent left superior vena cava (HP:0005301): A rare congenital vascular anomaly that results when the left superior cardinal vein caudal to the innominate vein fails to regress. Evidence: TAS. Frequency: Occasional (HP:0040283). (ORPHA:477817)
- Pes valgus (HP:0008081): An outward (valgus) deviation of the calcaneus relative to the longitudinal axis of the lower leg at the talocalcaneal (subtalar) joint, such that the heel is everted. Evidence: TAS. Frequency: Occasional (HP:0040283). (ORPHA:477817)
- Delayed speech and language development (HP:0000750): A degree of language development that is significantly below the norm for a child of a specified age. Evidence: TAS. Frequency: Very frequent (HP:0040281). (ORPHA:477817)
- Global developmental delay (HP:0001263): A delay in the achievement of motor or mental milestones in the domains of development of a child, including motor skills, speech and language, cognitive skills, and social and emotional skills. This term should only be used to describe children younger than five years of age. Evidence: TAS. Frequency: Very frequent (HP:0040281). (ORPHA:477817)
- Abnormal facial shape (HP:0001999): An abnormal morphology (form) of the face or its components. Evidence: TAS. Frequency: Very frequent (HP:0040281). (ORPHA:477817)
- Feeding difficulties in infancy (HP:0008872): Impaired feeding performance of an infant as manifested by difficulties such as weak and ineffective sucking, brief bursts of sucking, and falling asleep during sucking. There may be difficulties with chewing or maintaining attention. Evidence: TAS. Frequency: Very frequent (HP:0040281). (ORPHA:477817)
- Floppy infant (HP:0008947): Floppiness/hypotonia is defined as reduced resistance to passive movement of joints. Physical examination of floppy/hypotonic infants shows head lag, lack of shoulder and elbow muscle contraction on traction response, inability to tighten the shoulder girdle muscles (or slipping through) when held under the axillae, scarf sign (when the arm is pulled to the opposite side, the arm wraps around the neck with the elbow crossing midline), hyperdorsiflexion of the feet, easy apposition of the thumb against the forearm, feet touching the cheek with ease and without discomfort, frog leg position, and inverted U sign on ventral suspension (head, arms, and legs hanging down without elbow or knee flexion and the trunk rounded in a dome shape). Evidence: TAS. Frequency: Very frequent (HP:0040281). (ORPHA:477817)
- Delayed ability to walk (HP:0031936): A failure to achieve the ability to walk at an appropriate developmental stage. Most children learn to walk in a series of stages, and learn to walk short distances independently between 12 and 15 months. Evidence: TAS. Frequency: Very frequent (HP:0040281). (ORPHA:477817)
- Atypical behavior (HP:0000708): Atypical behavior is an abnormality in a person's actions that can be controlled or modulated by the will of the individual. While abnormal behaviors can be difficult to control, they are distinct from other abnormal actions that cannot be affected by the individual's will. Evidence: TAS. Frequency: Frequent (HP:0040282). (ORPHA:477817)
- Joint hypermobility (HP:0001382): The capability that a joint (or a group of joints) has to move, passively and/or actively, beyond normal limits along physiological axes. Evidence: TAS. Frequency: Frequent (HP:0040282). (ORPHA:477817)
- Failure to thrive in infancy (HP:0001531). Evidence: TAS. Frequency: Frequent (HP:0040282). (ORPHA:477817)
- Abnormal heart morphology (HP:0001627): Any structural anomaly of the heart. Evidence: TAS. Frequency: Frequent (HP:0040282). (ORPHA:477817)
- Abnormal foot morphology (HP:0001760): An abnormality of the skeleton of foot. Evidence: TAS. Frequency: Frequent (HP:0040282). (ORPHA:477817)
- Sleep disturbance (HP:0002360): An abnormal pattern in the quality, quantity, or characteristics of sleep. Evidence: TAS. Frequency: Frequent (HP:0040282). (ORPHA:477817)
- Distal muscle weakness (HP:0002460): Reduced strength of the musculature of the distal extremities. Evidence: TAS. Frequency: Frequent (HP:0040282). (ORPHA:477817)
- Distal sensory impairment (HP:0002936): An abnormal reduction in sensation in the distal portions of the extremities. Evidence: TAS. Frequency: Frequent (HP:0040282). (ORPHA:477817)
- Distal amyotrophy (HP:0003693): Muscular atrophy affecting muscles in the distal portions of the extremities. Evidence: TAS. Frequency: Frequent (HP:0040282). (ORPHA:477817)
These phenotypes are associated with the disease PMP22-RAI1 contiguous gene duplication syndrome (ORPHA:477817).